Phenotypes associated with the disease Autosomal recessive cerebellar ataxia-epilepsy-intellectual disability syndrome due to TUD deficiency (ORPHA:404493):
- Intellectual disability (HP:0001249): The term intellectual disability or intellectual developmental disorder is used to describe significantly sub-average intellectual and adaptive functioning based on clinical assessment and as measured by individually administered, appropriately normed, standardized and validated tests of intellectual functioning and adaptive behavior, with onset during the developmental period from infancy through adolescence. Evidence: TAS. Frequency: Very frequent (HP:0040281). (ORPHA:404493)
- Seizure (HP:0001250): A seizure is an intermittent abnormality of nervous system physiology characterized by a transient occurrence of signs and/or symptoms due to abnormal excessive or synchronous neuronal activity in the brain. Evidence: TAS. Frequency: Very frequent (HP:0040281). (ORPHA:404493)
- Abnormal facial shape (HP:0001999): An abnormal morphology (form) of the face or its components. Evidence: TAS. Frequency: Very frequent (HP:0040281). (ORPHA:404493)
- Ataxia (HP:0001251): Ataxia refers to impaired coordination of voluntary muscle movement. Cerebellar ataxia refers to ataxia due to dysfunction of the cerebellum. This causes a variety of elementary neurological deficits including asynergy (lack of coordination between muscles, limbs and joints), dysmetria (lack of ability to judge distances that can lead to under- or overshoot in grasping movements), and dysdiadochokinesia (inability to perform rapid movements requiring antagonizing muscle groups to be switched on and off repeatedly). Evidence: TAS. Frequency: Frequent (HP:0040282). (ORPHA:404493)
- Brachycephaly (HP:0000248): An abnormality of skull shape characterized by a decreased anterior-posterior diameter. That is, a cephalic index greater than 81%. Alternatively, an apparently shortened anteroposterior dimension (length) of the head compared to width. Evidence: TAS. Frequency: Occasional (HP:0040283). (ORPHA:404493)
- Generalized hypotonia (HP:0001290): Generalized muscular hypotonia (abnormally low muscle tone). Evidence: TAS. Frequency: Occasional (HP:0040283). (ORPHA:404493)